Phenotypes associated with the disease Papilloma of choroid plexus (ORPHA:2807):
- Hydrocephalus (HP:0000238): Hydrocephalus is an active distension of the ventricular system of the brain resulting from inadequate passage of CSF from its point of production within the cerebral ventricles to its point of absorption into the systemic circulation. Evidence: TAS. Frequency: Very frequent (HP:0040281). (ORPHA:2807)
- Visual impairment (HP:0000505): Visual impairment (or vision impairment) is vision loss (of a person) to such a degree as to qualify as an additional support need through a significant limitation of visual capability resulting from either disease, trauma, or congenital or degenerative conditions that cannot be corrected by conventional means, such as refractive correction, medication, or surgery. Evidence: TAS. Frequency: Occasional (HP:0040283). (ORPHA:2807)
- Seizure (HP:0001250): A seizure is an intermittent abnormality of nervous system physiology characterized by a transient occurrence of signs and/or symptoms due to abnormal excessive or synchronous neuronal activity in the brain. Evidence: TAS. Frequency: Occasional (HP:0040283). (ORPHA:2807)
- Hypertonia (HP:0001276): A condition in which there is increased muscle tone so that arms or legs, for example, are stiff and difficult to move. Evidence: TAS. Frequency: Occasional (HP:0040283). (ORPHA:2807)
- Neoplasm (HP:0002664): An organ or organ-system abnormality that consists of uncontrolled autonomous cell-proliferation which can occur in any part of the body as a benign or malignant neoplasm (tumor). Evidence: TAS. Frequency: Occasional (HP:0040283). (ORPHA:2807)
- Hemiplegia/hemiparesis (HP:0004374): Loss of strength in the arm, leg, and sometimes face on one side of the body. Hemiplegia refers to a severe or complete loss of strength, whereas hemiparesis refers to a relatively mild loss of strength. Evidence: TAS. Frequency: Occasional (HP:0040283). (ORPHA:2807)
- Abnormal nervous system morphology (HP:0012639): A structural anomaly of the nervous system. Evidence: TAS. Frequency: Very frequent (HP:0040281). (ORPHA:2807)
- Cognitive impairment (HP:0100543): Abnormal cognition is characterized by deficits in thinking, reasoning, or remembering. Evidence: TAS. Frequency: Occasional (HP:0040283). (ORPHA:2807)
- Choroid plexus papilloma (HP:0200022): Choroid plexus papilloma is a histologically benign neoplasm located in the ventricular system of the choroid plexus. Evidence: TAS. Frequency: Very frequent (HP:0040281). (ORPHA:2807)